- Recurrent otitis media (HP:0000403): Increased susceptibility to otitis media, as manifested by recurrent episodes of otitis media. Evidence: PCS. (PMID:26121085)
- Polygenic inheritance (HP:0010982): A mode of inheritance that depends on a mixture of major and minor genetic determinants possibly together with environmental factors. Diseases inherited in this manner are termed complex diseases. Evidence: PCS. (PMID:26121085)
- Autosomal dominant inheritance (HP:0000006): A mode of inheritance that is observed for traits related to a gene encoded on one of the autosomes (i.e., the human chromosomes 1-22) in which a trait manifests in heterozygotes. In the context of medical genetics, an autosomal dominant disorder is caused when a single copy of the mutant allele is present. Males and females are affected equally, and can both transmit the disorder with a risk of 50% for each child of inheriting the mutant allele. Evidence: IEA. (OMIM:166760)
These phenotypes are associated with the disease otitis media, susceptibility to (OMIM:166760).